- Type I transferrin isoform profile (HP:0003642): Abnormal transferrin isoform profile consistent with a type I congenital disorder of glycosylation. In the traditional nomenclature for congenital disorders of glycosylation, absence of entire glycans was designated type I, and loss of one or more monosaccharides as type II. Evidence: PCS. Frequency: 1/1. (PMID:22305527)
- Strabismus (HP:0000486): A misalignment of the eyes so that the visual axes deviate from bifoveal fixation. The classification of strabismus may be based on a number of features including the relative position of the eyes, whether the deviation is latent or manifest, intermittent or constant, concomitant or otherwise and according to the age of onset and the relevance of any associated refractive error. Evidence: PCS. Frequency: 1/1. (PMID:22305527)
- Decreased liver function (HP:0001410): Reduced ability of the liver to perform its functions. Evidence: PCS. Frequency: 1/1. (PMID:22305527)
- Delayed ability to walk (HP:0031936): A failure to achieve the ability to walk at an appropriate developmental stage. Most children learn to walk in a series of stages, and learn to walk short distances independently between 12 and 15 months. Evidence: PCS. Frequency: 1/1. (PMID:22305527)
- Hypotonia (HP:0001252): Hypotonia is an abnormally low muscle tone (the amount of tension or resistance to movement in a muscle). Even when relaxed, muscles have a continuous and passive partial contraction which provides some resistance to passive stretching. Hypotonia thus manifests as diminished resistance to passive stretching. Hypotonia is not the same as muscle weakness, although the two conditions can co-exist. Evidence: PCS. Frequency: 1/1. (PMID:22305527)
- Global developmental delay (HP:0001263): A delay in the achievement of motor or mental milestones in the domains of development of a child, including motor skills, speech and language, cognitive skills, and social and emotional skills. This term should only be used to describe children younger than five years of age. Evidence: PCS. Frequency: 1/1. (PMID:22305527)
- Infantile onset (HP:0003593): Onset of signs or symptoms of disease between 28 days to one year of life. Evidence: PCS. Frequency: 1/1. (PMID:22305527)
- Gastroesophageal reflux (HP:0002020): A condition in which the stomach contents leak backwards from the stomach into the esophagus through the lower esophageal sphincter. Evidence: PCS. Frequency: 1/1. (PMID:22305527)
- Failure to thrive (HP:0001508): Failure to thrive (FTT) refers to a child whose physical growth is substantially below the norm. Evidence: PCS. Frequency: 1/1. (PMID:22305527)
- Osteopenia (HP:0000938): Osteopenia is a term to define bone density that is not normal but also not as low as osteoporosis. By definition from the World Health Organization osteopenia is defined by bone densitometry as a T score -1 to -2.5. Evidence: PCS. Frequency: 1/1. (PMID:22305527)
- Chronic constipation (HP:0012450): Constipation for longer than three months with fewer than 3 bowel movements per week, straining, lumpy or hard stools, and a sensation of anorectal obstruction or incomplete defecation. Evidence: PCS. Frequency: 1/1. (PMID:22305527)
- Autosomal recessive inheritance (HP:0000007): A mode of inheritance that is observed for traits related to a gene encoded on one of the autosomes (i.e., the human chromosomes 1-22) in which a trait manifests in individuals with two pathogenic alleles, either homozygotes (two copies of the same mutant allele) or compound heterozygotes (whereby each copy of a gene has a distinct mutant allele). Evidence: PCS. (PMID:22305527)
- Accelerated skeletal maturation (HP:0005616): An abnormally increased rate of skeletal maturation. Accelerated skeletal maturation can be diagnosed on the basis of an estimation of the bone age from radiographs of specific bones in the human body. Evidence: PCS. Frequency: 1/1. (PMID:22305527)
- Recurrent ear infections (HP:0410018): Increased susceptibility to ear infections as manifested by recurrent episodes of ear infections. Evidence: PCS. Frequency: 1/1. (PMID:22305527)
These phenotypes are associated with the disease DDOST-congenital disorder of glycosylation (OMIM:614507).